- Abnormality of metabolism/homeostasis (HP:0001939). Evidence: IEA. (OMIM:243080)
- Abnormality of the immune system (HP:0002715): An abnormality of the immune system. Evidence: IEA. (OMIM:243080)
- Autosomal recessive inheritance (HP:0000007): A mode of inheritance that is observed for traits related to a gene encoded on one of the autosomes (i.e., the human chromosomes 1-22) in which a trait manifests in individuals with two pathogenic alleles, either homozygotes (two copies of the same mutant allele) or compound heterozygotes (whereby each copy of a gene has a distinct mutant allele). Evidence: IEA. (OMIM:243080)
These phenotypes are associated with the disease inosine phosphorylase deficiency, immune defect due to (OMIM:243080).